Phenotypes associated with the disease Bardet-Biedl syndrome 8 (OMIM:615985):
- Renal dysplasia (HP:0000110): The presence of developmental dysplasia of the kidney. Evidence: TAS. Frequency: Occasional (HP:0040283). (OMIM:615985)
- Postaxial polydactyly (HP:0100259): A form of polydactyly in which the extra digit or digits are localized on the side of the fifth finger or fifth toe. Evidence: PCS. Frequency: 8/8. (PMID:14520415)
- Congenital onset (HP:0003577): A phenotypic abnormality that is present at birth. Evidence: PCS. Frequency: 8/8. (PMID:14520415)
- Situs inversus totalis (HP:0001696): A left-right reversal (or mirror reflection) of the anatomical location of the major thoracic and abdominal organs. Evidence: PCS. Frequency: 1/8. (PMID:14520415)
- Global developmental delay (HP:0001263): A delay in the achievement of motor or mental milestones in the domains of development of a child, including motor skills, speech and language, cognitive skills, and social and emotional skills. This term should only be used to describe children younger than five years of age. Evidence: PCS. Frequency: 8/8. (PMID:14520415)
- Autosomal recessive inheritance (HP:0000007): A mode of inheritance that is observed for traits related to a gene encoded on one of the autosomes (i.e., the human chromosomes 1-22) in which a trait manifests in individuals with two pathogenic alleles, either homozygotes (two copies of the same mutant allele) or compound heterozygotes (whereby each copy of a gene has a distinct mutant allele). Evidence: PCS. (PMID:14520415)
- Rod-cone dystrophy (HP:0000510): An inherited retinal disease subtype in which the rod photoreceptors appear to be more severely affected than the cone photoreceptors. Typical presentation is with nyctalopia (due to rod dysfunction) followed by loss of mid-peripheral field of vision, which gradually extends and leaves many patients with a small central island of vision due to the preservation of macular cones. Evidence: PCS. Frequency: 8/8. (PMID:14520415)
- Hypogonadism (HP:0000135): A decreased functionality of the gonad. Evidence: PCS. Frequency: 5/6. (PMID:14520415)
- Hypospadias (HP:0000047): Abnormal position of urethral meatus on the ventral penile shaft (underside) characterized by displacement of the urethral meatus from the tip of the glans penis to the ventral surface of the penis, scrotum, or perineum. Evidence: PCS. (PMID:14520415)
- Brachycephaly (HP:0000248): An abnormality of skull shape characterized by a decreased anterior-posterior diameter. That is, a cephalic index greater than 81%. Alternatively, an apparently shortened anteroposterior dimension (length) of the head compared to width. Evidence: PCS. Frequency: 8/8. (PMID:14520415)
- Intellectual disability (HP:0001249): The term intellectual disability or intellectual developmental disorder is used to describe significantly sub-average intellectual and adaptive functioning based on clinical assessment and as measured by individually administered, appropriately normed, standardized and validated tests of intellectual functioning and adaptive behavior, with onset during the developmental period from infancy through adolescence. Evidence: TAS. (OMIM:615985)
- Obesity (HP:0001513): Accumulation of substantial excess body fat. Evidence: PCS. Frequency: 8/8. (PMID:14520415)